- Lymphoma (HP:0002665): A cancer originating in lymphocytes and presenting as a solid tumor of lymhpoid cells. Evidence: TAS. Frequency: Very frequent (HP:0040281). (ORPHA:391)
- Lymphadenopathy (HP:0002716): Enlargement (swelling) of a lymph node. Evidence: TAS. Frequency: Very frequent (HP:0040281). (ORPHA:391)
- Cellular immunodeficiency (HP:0005374): An immunodeficiency characterized by defective cell-mediated immunity or humoral immunity. Evidence: TAS. Frequency: Very frequent (HP:0040281). (ORPHA:391)
- Fatigue (HP:0012378): A subjective feeling of tiredness characterized by a lack of energy and motivation. Evidence: TAS. Frequency: Very frequent (HP:0040281). (ORPHA:391)
- Hyperhidrosis (HP:0000975): Abnormal excessive perspiration (sweating) despite the lack of appropriate stimuli like hot and humid weather. Evidence: TAS. Frequency: Frequent (HP:0040282). (ORPHA:391)
- Pruritus (HP:0000989): Pruritus is an itch or a sensation that makes a person want to scratch. This term refers to an abnormally increased disposition to experience pruritus. Evidence: TAS. Frequency: Frequent (HP:0040282). (ORPHA:391)
- Weight loss (HP:0001824): Reduction of total body weight. Evidence: TAS. Frequency: Frequent (HP:0040282). (ORPHA:391)
- Fever (HP:0001945): Body temperature elevated above the normal range. Evidence: TAS. Frequency: Frequent (HP:0040282). (ORPHA:391)
- Anorexia (HP:0002039): Lack of desire to eat (loss of appetite). Evidence: TAS. Frequency: Frequent (HP:0040282). (ORPHA:391)
- Back pain (HP:0003418): An unpleasant sensation characterized by physical discomfort (such as pricking, throbbing, or aching) localized to the back. Evidence: TAS. Frequency: Frequent (HP:0040282). (ORPHA:391)
- Poor appetite (HP:0004396): A reduced desire to eat. Evidence: TAS. Frequency: Frequent (HP:0040282). (ORPHA:391)
- Elevated circulating C-reactive protein concentration (HP:0011227): The concentration of C-reactive protein in the blood circulation is above the upper limit of normal. Evidence: TAS. Frequency: Frequent (HP:0040282). (ORPHA:391)
- Cough (HP:0012735): A sudden, audible expulsion of air from the lungs through a partially closed glottis, preceded by inhalation. Evidence: TAS. Frequency: Frequent (HP:0040282). (ORPHA:391)
- Night sweats (HP:0030166): Occurrence of excessive sweating during sleep. Evidence: TAS. Frequency: Frequent (HP:0040282). (ORPHA:391)
- Chest pain (HP:0100749): An unpleasant sensation characterized by physical discomfort (such as pricking, throbbing, or aching) localized to the chest. Evidence: TAS. Frequency: Frequent (HP:0040282). (ORPHA:391)
- Skin rash (HP:0000988): A red eruption of the skin. Evidence: TAS. Frequency: Occasional (HP:0040283). (ORPHA:391)
- Ataxia (HP:0001251): Ataxia refers to impaired coordination of voluntary muscle movement. Cerebellar ataxia refers to ataxia due to dysfunction of the cerebellum. This causes a variety of elementary neurological deficits including asynergy (lack of coordination between muscles, limbs and joints), dysmetria (lack of ability to judge distances that can lead to under- or overshoot in grasping movements), and dysdiadochokinesia (inability to perform rapid movements requiring antagonizing muscle groups to be switched on and off repeatedly). Evidence: TAS. Frequency: Occasional (HP:0040283). (ORPHA:391)
- Splenomegaly (HP:0001744): Abnormal increased size of the spleen. Evidence: TAS. Frequency: Occasional (HP:0040283). (ORPHA:391)
- Increased total eosinophil count (HP:0001880): Increased count of eosinophils in the blood. Evidence: TAS. Frequency: Occasional (HP:0040283). (ORPHA:391)
- Decreased total lymphocyte count (HP:0001888): A reduced number of lymphocytes in the blood. Evidence: TAS. Frequency: Occasional (HP:0040283). (ORPHA:391)
- Anemia (HP:0001903): A reduction in erythrocytes volume or hemoglobin concentration. Evidence: TAS. Frequency: Occasional (HP:0040283). (ORPHA:391)
- Increased total leukocyte count (HP:0001974): An abnormal increase in the number of leukocytes in the blood. Evidence: TAS. Frequency: Occasional (HP:0040283). (ORPHA:391)
- Migraine (HP:0002076): Migraine is a chronic neurological disorder characterized by episodic attacks of headache and associated symptoms. Evidence: TAS. Frequency: Occasional (HP:0040283). (ORPHA:391)
- Respiratory insufficiency (HP:0002093). Evidence: TAS. Frequency: Occasional (HP:0040283). (ORPHA:391)
- Hemoptysis (HP:0002105): Coughing up (expectoration) of blood or blood-streaked sputum from the larynx, trachea, bronchi, or lungs. Evidence: TAS. Frequency: Occasional (HP:0040283). (ORPHA:391)
- Hepatomegaly (HP:0002240): Abnormally increased size of the liver. Evidence: TAS. Frequency: Occasional (HP:0040283). (ORPHA:391)
- Bone pain (HP:0002653): An unpleasant sensation characterized by physical discomfort (such as pricking, throbbing, or aching) localized to bone. Evidence: TAS. Frequency: Occasional (HP:0040283). (ORPHA:391)
- Neoplasm (HP:0002664): An organ or organ-system abnormality that consists of uncontrolled autonomous cell-proliferation which can occur in any part of the body as a benign or malignant neoplasm (tumor). Evidence: TAS. Frequency: Occasional (HP:0040283). (ORPHA:391)
- Osteolysis (HP:0002797): Osteolysis refers to the destruction of bone through bone resorption with removal or loss of calcium. Evidence: TAS. Frequency: Occasional (HP:0040283). (ORPHA:391)
- Bone marrow hypocellularity (HP:0005528): A reduced number of hematopoietic cells present in the bone marrow relative to marrow fat. Evidence: TAS. Frequency: Occasional (HP:0040283). (ORPHA:391)
- Peripheral neuropathy (HP:0009830): Peripheral neuropathy is a general term for any disorder of the peripheral nervous system. The main clinical features used to classify peripheral neuropathy are distribution, type (mainly demyelinating versus mainly axonal), duration, and course. Evidence: TAS. Frequency: Occasional (HP:0040283). (ORPHA:391)
- Increased circulating lactate dehydrogenase concentration (HP:0025435): An elevated level of the enzyme lactate dehydrogenase in the blood circulation. Evidence: TAS. Frequency: Occasional (HP:0040283). (ORPHA:391)
These phenotypes are associated with the disease Classic Hodgkin lymphoma (ORPHA:391).